- Juvenile onset (HP:0003621): Onset of signs or symptoms of disease between the age of 5 and 15 years. Evidence: PCS. Frequency: 3/4. (PMID:25774885)
- Hypoplasia of the uterus (HP:0000013): Underdevelopment of the uterus. Evidence: PCS. Frequency: 4/4. (PMID:25774885)
- Early young adult onset (HP:0025708): Onset of disease at an age of greater than or equal to 16 to under 19 years. Evidence: PCS. Frequency: 1/4. (PMID:25774885)
- Short stature (HP:0004322): A height below that which is expected according to age and gender norms. Although there is no universally accepted definition of short stature, many refer to "short stature" as height more than 2 standard deviations below the mean for age and gender (or below the 3rd percentile for age and gender dependent norms). Evidence: PCS. Frequency: 2/4. (PMID:25774885)
- Delayed skeletal maturation (HP:0002750): A decreased rate of skeletal maturation. Delayed skeletal maturation can be diagnosed on the basis of an estimation of the bone age from radiographs of specific bones in the human body. Evidence: PCS. (PMID:25774885)
- Elevated circulating luteinizing hormone level (HP:0011969): An elevated concentration of luteinizing hormone in the blood. Evidence: PCS. Frequency: 4/4. (PMID:25774885)
- Elevated circulating follicle stimulating hormone level (HP:0008232): An elevated concentration of follicle-stimulating hormone in the blood. Evidence: PCS. Frequency: 4/4. (PMID:25774885)
- Autosomal recessive inheritance (HP:0000007): A mode of inheritance that is observed for traits related to a gene encoded on one of the autosomes (i.e., the human chromosomes 1-22) in which a trait manifests in individuals with two pathogenic alleles, either homozygotes (two copies of the same mutant allele) or compound heterozygotes (whereby each copy of a gene has a distinct mutant allele). Evidence: PCS. (PMID:25774885)
- Decreased serum estradiol (HP:0008214): A reduction below normal concentration of estradiol in the circulation. Evidence: PCS. Frequency: 3/4. (PMID:25774885)
- Primary amenorrhea (HP:0000786). Evidence: PCS. Frequency: 4/4. (PMID:25774885)
These phenotypes are associated with the disease ovarian dysgenesis 5 (OMIM:617690).